- Heinz bodies (HP:0020082): A type of erythrocyte inclusion composed of denatured hemoglobin. Evidence: IEA. (OMIM:140700)
- Heinz body anemia (HP:0005511): Anemia characterized by abnormal intracellular inclusions, composed of denatured hemoglobin, found on the membrane of red blood cells. Evidence: IEA. (OMIM:140700)
- Autosomal dominant inheritance (HP:0000006): A mode of inheritance that is observed for traits related to a gene encoded on one of the autosomes (i.e., the human chromosomes 1-22) in which a trait manifests in heterozygotes. In the context of medical genetics, an autosomal dominant disorder is caused when a single copy of the mutant allele is present. Males and females are affected equally, and can both transmit the disorder with a risk of 50% for each child of inheriting the mutant allele. Evidence: IEA. (OMIM:140700)
- Nonspherocytic hemolytic anemia (HP:0001930). Evidence: IEA. (OMIM:140700)
These phenotypes are associated with the disease Heinz body anemia (OMIM:140700).